- Premature birth (HP:0001622): The birth of a baby of less than 37 weeks of gestational age. Evidence: TAS. Frequency: Very frequent (HP:0040281). (ORPHA:88621)
- Increased total eosinophil count (HP:0001880): Increased count of eosinophils in the blood. Evidence: TAS. Frequency: Very frequent (HP:0040281). (ORPHA:88621)
- Neonatal respiratory distress (HP:0002643): Respiratory difficulty as newborn. Evidence: TAS. Frequency: Very frequent (HP:0040281). (ORPHA:88621)
- Desquamation of skin soon after birth (HP:0007549). Evidence: TAS. Frequency: Very frequent (HP:0040281). (ORPHA:88621)
- Ichthyosis (HP:0008064): An abnormality of the skin characterized the presence of excessive amounts of dry surface scales on the skin resulting from an abnormality of keratinization. Evidence: TAS. Frequency: Very frequent (HP:0040281). (ORPHA:88621)
These phenotypes are associated with the disease Ichthyosis-prematurity syndrome (ORPHA:88621).